Phenotypes associated with the disease Idiopathic chronic eosinophilic pneumonia (ORPHA:2902):
- Abnormal pulmonary thoracic imaging finding (HP:0031983): This term groups terms representing abnormal findings derived from chest X-ray investigation of the lung. In general, lung abnormalities can manifest as opacities (areas of increased density) or as regions with decreased density. Evidence: TAS. Frequency: Very frequent (HP:0040281). (ORPHA:2902)
- Parenchymal consolidation (HP:0032177): Consolidation refers to an exudate or other product of disease that replaces alveolar air, rendering the lung solid (as in infective pneumonia). Evidence: TAS. Frequency: Very frequent (HP:0040281). (ORPHA:2902)
- Atopic dermatitis (HP:0001047): Atopic dermatitis (AD) or atopic eczema is an itchy, inflammatory skin condition with a predilection for the skin flexures. It is characterized by poorly defined erythema with edema, vesicles, and weeping in the acute stage and skin thickening (lichenification) in the chronic stage. Evidence: TAS. Frequency: Frequent (HP:0040282). (ORPHA:2902)
- Increased total leukocyte count (HP:0001974): An abnormal increase in the number of leukocytes in the blood. Evidence: TAS. Frequency: Frequent (HP:0040282). (ORPHA:2902)
- Restrictive ventilatory defect (HP:0002091): A functional defect characterized by reduced total lung capacity (TLC) not associated with abnormalities of expiratory airflow or airway resistance. Spirometrically, a restrictive defect is defined as FEV1 (forced expiratory volume in 1 second) and FVC (forced vital capacity) less than 80 per cent. Restrictive lung disease may be caused by alterations in lung parenchyma or because of a disease of the pleura, chest wall, or neuromuscular apparatus. Evidence: TAS. Frequency: Frequent (HP:0040282). (ORPHA:2902)
- Dyspnea (HP:0002094): Difficult or labored breathing. Dyspnea is a subjective feeling only the patient can rate, e.g., on a Borg scale. Evidence: TAS. Frequency: Frequent (HP:0040282). (ORPHA:2902)
- Asthma (HP:0002099): Asthma is characterized by increased responsiveness of the tracheobronchial tree to multiple stimuli, leading to narrowing of the air passages with resultant dyspnea, cough, and wheezing. Evidence: TAS. Frequency: Frequent (HP:0040282). (ORPHA:2902)
- Autoimmunity (HP:0002960): The occurrence of an immune reaction against the organism's own cells or tissues. Evidence: TAS. Frequency: Frequent (HP:0040282). (ORPHA:2902)
- Increased circulating IgE concentration (HP:0003212): An abnormally increased overall level of immunoglobulin E in blood. Evidence: TAS. Frequency: Frequent (HP:0040282). (ORPHA:2902)
- Elevated erythrocyte sedimentation rate (HP:0003565): An increased erythrocyte sedimentation rate (ESR). The ESR is a test that measures the distance that erythrocytes have fallen after one hour in a vertical column of anticoagulated blood under the influence of gravity. The ESR is a nonspecific finding. An elevation may indicate inflammation or may be caused by any condition that elevates fibrinogen. Evidence: TAS. Frequency: Frequent (HP:0040282). (ORPHA:2902)
- Hypersensitivity pneumonitis (HP:0006516): Hypersensitivity pneumonitis involves inhalation of an antigen. This leads to an exaggerated immune response and a following inflammation of the alveoli within the lungs. The main feature of chronic hypersensitivity pneumonitis on lung biopsies is expansion of the interstitium by lymphocytes accompanied by an occasional multinucleated giant cell or loose granuloma. After exposure to the provoking antigen, following symptoms can be seen: fever, chills, malaise, cough, hemoptysis, chest tightness, dyspnea, rash, swelling and headache and can be completely reversible, based on the duration of the illness, categorized as acute (HP:0011009), subacute (HP:0011011), and chronic (HP:0011010). Evidence: TAS. Frequency: Frequent (HP:0040282). (ORPHA:2902)
- Elevated circulating C-reactive protein concentration (HP:0011227): The concentration of C-reactive protein in the blood circulation is above the upper limit of normal. Evidence: TAS. Frequency: Frequent (HP:0040282). (ORPHA:2902)
- Hypoxemia (HP:0012418): An abnormally low level of blood oxygen. Evidence: TAS. Frequency: Frequent (HP:0040282). (ORPHA:2902)
- Wheezing (HP:0030828): A high-pitched whistling sound associated with labored breathing. Evidence: TAS. Frequency: Frequent (HP:0040282). (ORPHA:2902)
- Crackles (HP:0030830): Crackles are discontinuous, explosive, and nonmusical adventitious lung sounds normally heard in inspiration and sometimes during expiration. Crackles are usually classified as fine and coarse crackles based on their duration, loudness, pitch, timing in the respiratory cycle, and relationship to coughing and changing body position. Evidence: TAS. Frequency: Frequent (HP:0040282). (ORPHA:2902)
- Nonproductive cough (HP:0031246): A cough that does not produce phlegm or mucus. Evidence: TAS. Frequency: Frequent (HP:0040282). (ORPHA:2902)
- Sputum eosinophilia (HP:0032017): An increased proportion of eosinophils in sputum in the differentiated cell count. Evidence: TAS. Frequency: Frequent (HP:0040282). (ORPHA:2902)
- Severely increased total eosinophil count (HP:0032061): Severe increase in circulating eosinophils, usually characterized as more than 1500 eosinophils per microlitre. Evidence: TAS. Frequency: Frequent (HP:0040282). (ORPHA:2902)
- Weight loss (HP:0001824): Reduction of total body weight. Evidence: TAS. Frequency: Occasional (HP:0040283). (ORPHA:2902)
- Fever (HP:0001945): Body temperature elevated above the normal range. Evidence: TAS. Frequency: Occasional (HP:0040283). (ORPHA:2902)
- Arthralgia (HP:0002829): Joint pain. Evidence: TAS. Frequency: Occasional (HP:0040283). (ORPHA:2902)
- Asthenia (HP:0025406): A state characterized by a feeling of weakness and loss of strength leading to a generalized weakness of the body. Evidence: TAS. Frequency: Occasional (HP:0040283). (ORPHA:2902)
- Night sweats (HP:0030166): Occurrence of excessive sweating during sleep. Evidence: TAS. Frequency: Occasional (HP:0040283). (ORPHA:2902)
- Pleural effusion (HP:0002202): The presence of an excessive amount of fluid in the pleural cavity. Evidence: TAS. Frequency: Very rare (HP:0040284). (ORPHA:2902)
- Abnormality of the gastrointestinal tract (HP:0011024): An abnormality of the gastrointestinal tract. Evidence: TAS. Frequency: Very rare (HP:0040284). (ORPHA:2902)
- Generalized abnormality of skin (HP:0011354): An abnormality of the skin that is not localized to any one particular region. Evidence: TAS. Frequency: Very rare (HP:0040284). (ORPHA:2902)
- Atelectasis (HP:0100750): Collapse of part of a lung associated with absence of inflation (air) of that part. Evidence: TAS. Frequency: Very rare (HP:0040284). (ORPHA:2902)